- Congenital onset (HP:0003577): A phenotypic abnormality that is present at birth. Evidence: PCS. Frequency: 3/3. (PMID:22678063)
- Sensorineural hearing impairment (HP:0000407): A type of hearing impairment in one or both ears related to an abnormal functionality of the cochlear nerve. Evidence: PCS. Frequency: 3/3. Onset: Congenital onset (HP:0003577). (PMID:22678063)
- Autosomal recessive inheritance (HP:0000007): A mode of inheritance that is observed for traits related to a gene encoded on one of the autosomes (i.e., the human chromosomes 1-22) in which a trait manifests in individuals with two pathogenic alleles, either homozygotes (two copies of the same mutant allele) or compound heterozygotes (whereby each copy of a gene has a distinct mutant allele). Evidence: PCS. (PMID:22678063)
These phenotypes are associated with the disease autosomal recessive nonsyndromic hearing loss 98 (OMIM:614861).